- Emphysema (HP:0002097). Evidence: IEA. (OMIM:130700)
- Chronic pulmonary obstruction (HP:0006510): An anomaly that is characterized progressive airflow obstruction that is only partly reversible, inflammation in the airways, and systemic effects or comorbities. Evidence: IEA. (OMIM:130700)
- Chronic bronchitis (HP:0004469): Chronic inflammation of the bronchi. Evidence: IEA. (OMIM:130700)
These phenotypes are associated with the disease emphysema, hereditary pulmonary (OMIM:130700).